- Nuclear cataract (HP:0100018): A nuclear cataract is an opacity or clouding that develops in the lens nucleus. That is, a nuclear cataract is one that is located in the center of the lens. The nucleus tends to darken changing from clear to yellow and sometimes brown. Evidence: TAS. (OMIM:611391)
- Juvenile onset (HP:0003621): Onset of signs or symptoms of disease between the age of 5 and 15 years. Evidence: PCS. Frequency: 10/11. (PMID:17225135)
- Childhood onset (HP:0011463): Onset of disease at the age of between 1 and 5 years. Evidence: PCS. Frequency: 1/11. (PMID:17225135)
- Cortical cataract (HP:0100019): A cataract which affects the layer of the lens surrounding the nucleus, i.e., the lens cortex. It is identified by its unique wedge or spoke appearance. Evidence: PCS. Frequency: 3/3. Onset: Juvenile onset (HP:0003621). (PMID:17225135)
- Autosomal recessive inheritance (HP:0000007): A mode of inheritance that is observed for traits related to a gene encoded on one of the autosomes (i.e., the human chromosomes 1-22) in which a trait manifests in individuals with two pathogenic alleles, either homozygotes (two copies of the same mutant allele) or compound heterozygotes (whereby each copy of a gene has a distinct mutant allele). Evidence: TAS. (OMIM:611391)
- Lamellar cataract (HP:0007971): A congenital cataract in which opacity is limited to layers of the lens external to the nucleus (i.e., the perinuclear region), i.e., between the nuclear and cortical layers of the lens. Evidence: IEA. (OMIM:611391)
- Autosomal dominant inheritance (HP:0000006): A mode of inheritance that is observed for traits related to a gene encoded on one of the autosomes (i.e., the human chromosomes 1-22) in which a trait manifests in heterozygotes. In the context of medical genetics, an autosomal dominant disorder is caused when a single copy of the mutant allele is present. Males and females are affected equally, and can both transmit the disorder with a risk of 50% for each child of inheriting the mutant allele. Evidence: PCS. (PMID:17225135)
These phenotypes are associated with the disease cataract 33 (OMIM:611391).